Phenotypes associated with the disease laryngeal adductor paralysis (OMIM:150270):
- Hoarse voice (HP:0001609): Hoarseness refers to a change in the pitch or quality of the voice, with the voice sounding weak, very breathy, scratchy, or husky. Evidence: TAS. Onset: Congenital onset (HP:0003577). (OMIM:150270)
- Paralysis (HP:0003470): Paralysis of voluntary muscles means loss of contraction due to interruption of one or more motor pathways from the brain to the muscle fibers. Although the word paralysis is often used interchangeably to mean either complete or partial loss of muscle strength, it is preferable to use paralysis or plegia for complete or severe loss of muscle strength, and paresis for partial or slight loss. Motor paralysis results from deficits of the upper motor neurons (corticospinal, corticobulbar, or subcorticospinal). Motor paralysis is often accompanied by an impairment in the facility of movement. Evidence: IEA. (OMIM:150270)
- Autosomal dominant inheritance (HP:0000006): A mode of inheritance that is observed for traits related to a gene encoded on one of the autosomes (i.e., the human chromosomes 1-22) in which a trait manifests in heterozygotes. In the context of medical genetics, an autosomal dominant disorder is caused when a single copy of the mutant allele is present. Males and females are affected equally, and can both transmit the disorder with a risk of 50% for each child of inheriting the mutant allele. Evidence: PCS. (PMID:709905)